Phenotypes associated with the disease Oligocone trichromacy (ORPHA:75378):
- Abnormal electroretinogram (HP:0000512): Any abnormality of the electrical responses of various cell types in the retina as measured by electroretinography. Evidence: TAS. Frequency: Very frequent (HP:0040281). (ORPHA:75378)
- Photophobia (HP:0000613): Excessive sensitivity to light with the sensation of discomfort or pain in the eyes due to exposure to bright light. Evidence: TAS. Frequency: Frequent (HP:0040282). (ORPHA:75378)